Phenotypes associated with the disease syndactyly-camptodactyly and clinodactyly of fifth fingers-bifid toes syndrome (OMIM:615170):
- Camptodactyly (HP:0012385): The distal interphalangeal joint and/or the proximal interphalangeal joint of the fingers or toes cannot be extended to 180 degrees by either active or passive extension. Evidence: IEA. (OMIM:615170)
- Short foot (HP:0001773): A measured foot length that is more than 2 SD below the mean for a newborn of 27 - 41 weeks gestation, or foot that is less than the 3rd centile for individuals from birth to 16 years of age (objective). Alternatively, a foot that appears disproportionately short (subjective). Evidence: TAS. (OMIM:615170)
- Short palm (HP:0004279): Short palm. Evidence: TAS. (OMIM:615170)
- Short metacarpal (HP:0010049): Diminished length of one or more metacarpal bones in relation to the others of the same hand or to the contralateral metacarpal. Evidence: TAS. (OMIM:615170)
- Ankylosis (HP:0031013): A reduction of joint mobility resulting from changes involving the articular surfaces. Evidence: IEA. (OMIM:615170)
- Adducted thumb (HP:0001181): In the resting position, the tip of the thumb is on, or near, the palm, close to the base of the fourth or fifth finger. Evidence: TAS. (OMIM:615170)
- Clinodactyly (HP:0030084): An angulation of a digit at an interphalangeal joint in the plane of the palm (finger) or sole (toe). Evidence: IEA. (OMIM:615170)
- Syndactyly (HP:0001159): Webbing or fusion of the fingers or toes, involving soft parts only or including bone structure. Bony fusions are referred to as "bony" syndactyly if the fusion occurs in a radio-ulnar axis. Fusions of bones of the fingers or toes in a proximo-distal axis are referred to as "symphalangism". Evidence: TAS. (OMIM:615170)
- Short thumb (HP:0009778): Hypoplasia (congenital reduction in size) of the thumb. Evidence: TAS. (OMIM:615170)
- Autosomal dominant inheritance (HP:0000006): A mode of inheritance that is observed for traits related to a gene encoded on one of the autosomes (i.e., the human chromosomes 1-22) in which a trait manifests in heterozygotes. In the context of medical genetics, an autosomal dominant disorder is caused when a single copy of the mutant allele is present. Males and females are affected equally, and can both transmit the disorder with a risk of 50% for each child of inheriting the mutant allele. Evidence: TAS. (OMIM:615170)